Phenotypes associated with the disease spermatogenic failure, X-linked, 6 (OMIM:301101):
- Abnormal male external genitalia morphology (HP:0000032): Any structural abnormality of male external genitalia. Evidence: PCS. Frequency: 0/2. (PMID:34202084)
- Male infertility (HP:0003251). Evidence: PCS. Frequency: 2/2. (PMID:34202084)
- Reduced sperm motility (HP:0012207): An abnormal reduction in the mobility of ejaculated sperm. Evidence: PCS. Frequency: 1/2. (PMID:34202084)
- Absent sperm axoneme central pair complex (HP:0033525): Absence of the central pair of microtubules in the sperm axoneme, thereby forming a 9+0 pattern instead of the normal 9+2 pattern. Evidence: PCS. Frequency: 2/2. (PMID:34202084)
- Short sperm flagella (HP:0032559): Sperm cells with abnormally short flagella. Evidence: PCS. Frequency: 2/2. (PMID:34202084)
- Coiled sperm flagella (HP:0032560): Sperm cells whose flagella are twisted (coiled). Evidence: PCS. Frequency: 2/2. (PMID:34202084)
- Reduced progressive sperm motility (HP:0034011): A reduced proportion of sperm that move in a straight line or large circles; alternatively, an increased proportion of sperm that move in tight circles or in some other non-linear fashion. Evidence: PCS. Frequency: 2/2. (PMID:34202084)
- Young adult onset (HP:0011462): Onset of disease at the age of between 16 and 40 years. Evidence: PCS. Frequency: 2/2. (PMID:34202084)
- Microcephalic sperm head (HP:0032561): Decreased size of the head of sperm. Evidence: PCS. Frequency: 2/2. (PMID:34202084)
- Recurrent bronchitis (HP:0002837): An increased susceptibility to bronchitis as manifested by a history of recurrent bronchitis. Evidence: PCS. Frequency: 0/2. (PMID:34202084)
- Recurrent otitis media (HP:0000403): Increased susceptibility to otitis media, as manifested by recurrent episodes of otitis media. Evidence: PCS. Frequency: 0/2. (PMID:34202084)
- X-linked inheritance (HP:0001417): A mode of inheritance that is observed for traits related to a gene encoded on the X chromosome. Evidence: PCS. (PMID:34202084)
- Recurrent pneumonia (HP:0006532): An increased susceptibility to pneumonia as manifested by a history of recurrent episodes of pneumonia. Evidence: PCS. Frequency: 0/2. (PMID:34202084)